Phenotypes associated with the disease hypoalphalipoproteinemia, primary, 1 (OMIM:604091):
- Decreased circulating HDL-C concentration (HP:0003233): The concentration of high-density lipoprotein cholesterol in the blood circulation is below the lower limit of normal. Evidence: PCS. Frequency: 6/7. (PMID:30503498)
- Hypertriglyceridemia (HP:0002155): An abnormal increase in the level of triglycerides in the blood. Evidence: PCS. Frequency: 0/7. (PMID:30503498)
- Myocardial infarction (HP:0001658): Necrosis of the myocardium caused by an obstruction of the blood supply to the heart and often associated with chest pain, shortness of breath, palpitations, and anxiety as well as characteristic EKG findings and elevation of serum markers including creatine kinase-MB fraction and troponin. Evidence: PCS. (PMID:10431236)
- Premature coronary artery atherosclerosis (HP:0005181): Reduction of the diameter of the coronary arteries as the result of an accumulation of atheromatous plaques within the walls of the coronary arteries before age of 45. Evidence: PCS. Frequency: 2/4. (PMID:7627690)
- Autosomal dominant inheritance (HP:0000006): A mode of inheritance that is observed for traits related to a gene encoded on one of the autosomes (i.e., the human chromosomes 1-22) in which a trait manifests in heterozygotes. In the context of medical genetics, an autosomal dominant disorder is caused when a single copy of the mutant allele is present. Males and females are affected equally, and can both transmit the disorder with a risk of 50% for each child of inheriting the mutant allele. Evidence: PCS. (PMID:9888879)